- Autosomal dominant inheritance (HP:0000006): A mode of inheritance that is observed for traits related to a gene encoded on one of the autosomes (i.e., the human chromosomes 1-22) in which a trait manifests in heterozygotes. In the context of medical genetics, an autosomal dominant disorder is caused when a single copy of the mutant allele is present. Males and females are affected equally, and can both transmit the disorder with a risk of 50% for each child of inheriting the mutant allele. Evidence: IEA. (OMIM:159500)
- Abnormality of the eye (HP:0000478): Any abnormality of the eye, including location, spacing, and intraocular abnormalities. Evidence: IEA. (OMIM:159500)
These phenotypes are associated with the disease myelinated optic nerve fibers (OMIM:159500).